Phenotypes associated with the disease oocyte/zygote/embryo maturation arrest 18 (OMIM:620332):
- Female infertility (HP:0008222). Evidence: PCS. Frequency: 5/5. (PMID:30877238)
- Young adult onset (HP:0011462): Onset of disease at the age of between 16 and 40 years. Evidence: PCS. Frequency: 5/5. (PMID:30877238)
- Autosomal recessive inheritance (HP:0000007): A mode of inheritance that is observed for traits related to a gene encoded on one of the autosomes (i.e., the human chromosomes 1-22) in which a trait manifests in individuals with two pathogenic alleles, either homozygotes (two copies of the same mutant allele) or compound heterozygotes (whereby each copy of a gene has a distinct mutant allele). Evidence: PCS. (PMID:30877238)